- Female infertility (HP:0008222). Evidence: PCS. Frequency: 3/3. (PMID:34779126)
- Young adult onset (HP:0011462): Onset of disease at the age of between 16 and 40 years. Evidence: PCS. Frequency: 3/3. (PMID:34779126)
- Amenorrhea (HP:0000141): Absence of menses for an interval of time equivalent to a total of more than (or equal to) 3 previous cycles or 6 months. Evidence: PCS. Frequency: 0/3. (PMID:34779126)
- Autosomal recessive inheritance (HP:0000007): A mode of inheritance that is observed for traits related to a gene encoded on one of the autosomes (i.e., the human chromosomes 1-22) in which a trait manifests in individuals with two pathogenic alleles, either homozygotes (two copies of the same mutant allele) or compound heterozygotes (whereby each copy of a gene has a distinct mutant allele). Evidence: PCS. (PMID:34779126)
These phenotypes are associated with the disease oocyte/zygote/embryo maturation arrest 20 (OMIM:620383).